Phenotypes associated with the disease Hypertrichosis cubiti (ORPHA:2220):
- Joint hypermobility (HP:0001382): The capability that a joint (or a group of joints) has to move, passively and/or actively, beyond normal limits along physiological axes. Evidence: TAS. Frequency: Occasional (HP:0040283). (ORPHA:2220)
- Generalized hirsutism (HP:0002230): Abnormally increased hair growth over much of the entire body. Evidence: TAS. Frequency: Very frequent (HP:0040281). (ORPHA:2220)
- Micromelia (HP:0002983): The presence of abnormally small extremities. Evidence: TAS. Frequency: Very frequent (HP:0040281). (ORPHA:2220)
- Severe short stature (HP:0003510): A severe degree of short stature, more than -4 SD from the mean corrected for age and sex. Evidence: TAS. Frequency: Very frequent (HP:0040281). (ORPHA:2220)
- Rhizomelia (HP:0008905): Disproportionate shortening of the proximal segment of limbs (i.e. the femur and humerus). Evidence: TAS. Frequency: Very frequent (HP:0040281). (ORPHA:2220)
- Abnormality of the elbow (HP:0009811): An anomaly of the joint that connects the upper and the lower arm. Evidence: TAS. Frequency: Very frequent (HP:0040281). (ORPHA:2220)
- Abnormal skin morphology (HP:0011121): Any morphological abnormality of the skin. Evidence: TAS. Frequency: Very frequent (HP:0040281). (ORPHA:2220)
- Round face (HP:0000311): The facial appearance is more circular than usual as viewed from the front. Evidence: TAS. Frequency: Frequent (HP:0040282). (ORPHA:2220)
- Facial asymmetry (HP:0000324): An abnormal difference between the left and right sides of the face. Evidence: TAS. Frequency: Frequent (HP:0040282). (ORPHA:2220)
- Mutism (HP:0002300): Complete lack of speech or verbal communication in a person despite attempts to engage in conversation. Mutism as a phenomena assumes the individual has previous capacity for speech and in the pediatric population it assumes that the person is past the age of typical language development. Evidence: TAS. Frequency: Frequent (HP:0040282). (ORPHA:2220)
- Aphasia (HP:0002381): An acquired language impairment of some or all of the abilities to produce or comprehend speech and to read or write. Evidence: TAS. Frequency: Frequent (HP:0040282). (ORPHA:2220)
- Echolalia (HP:0010529): Echolalia is the automatic imitative repetition of sounds, words, or phrases in the absence of explicit awareness. The repeated words or phrases are typically odd or used in a non-social manner. These can be words or phrases that the affected individual has heard or invented. Evidence: TAS. Frequency: Frequent (HP:0040282). (ORPHA:2220)
- Microcephaly (HP:0000252): Head circumference below 2 standard deviations below the mean for age and gender. Evidence: TAS. Frequency: Occasional (HP:0040283). (ORPHA:2220)
- Abnormality of the face (HP:0000271): An abnormality of the face. Evidence: TAS. Frequency: Occasional (HP:0040283). (ORPHA:2220)
- High forehead (HP:0000348): An abnormally increased height of the forehead. Evidence: TAS. Frequency: Occasional (HP:0040283). (ORPHA:2220)
- Prominent nasal bridge (HP:0000426): Anterior positioning of the nasal root in comparison to the usual positioning for age. Evidence: TAS. Frequency: Occasional (HP:0040283). (ORPHA:2220)
- Abnormality of the neck (HP:0000464): An abnormality of the neck. Evidence: TAS. Frequency: Occasional (HP:0040283). (ORPHA:2220)
- Abnormal eyelid morphology (HP:0000492): An abnormality of the eyelids. Evidence: TAS. Frequency: Occasional (HP:0040283). (ORPHA:2220)
- Downslanted palpebral fissures (HP:0000494): The palpebral fissure inclination is more than two standard deviations below the mean. Evidence: TAS. Frequency: Occasional (HP:0040283). (ORPHA:2220)
- Abnormal eyelash morphology (HP:0000499): An abnormality of the eyelashes. Evidence: TAS. Frequency: Occasional (HP:0040283). (ORPHA:2220)
- Ptosis (HP:0000508): The upper eyelid margin is positioned 3 mm or more lower than usual and covers the superior portion of the iris (objective); or, the upper lid margin obscures at least part of the pupil (subjective). Evidence: TAS. Frequency: Occasional (HP:0040283). (ORPHA:2220)
- Thick eyebrow (HP:0000574): Increased density/number and/or increased diameter of eyebrow hairs. Evidence: TAS. Frequency: Occasional (HP:0040283). (ORPHA:2220)
- Abnormal nasolacrimal system morphology (HP:0000614): An abnormality of the nasolacrimal drainage system, which serves as a conduit for tear flow from the external eye to the nasal cavity. Evidence: TAS. Frequency: Occasional (HP:0040283). (ORPHA:2220)
- Intellectual disability (HP:0001249): The term intellectual disability or intellectual developmental disorder is used to describe significantly sub-average intellectual and adaptive functioning based on clinical assessment and as measured by individually administered, appropriately normed, standardized and validated tests of intellectual functioning and adaptive behavior, with onset during the developmental period from infancy through adolescence. Evidence: TAS. Frequency: Occasional (HP:0040283). (ORPHA:2220)
- Global developmental delay (HP:0001263): A delay in the achievement of motor or mental milestones in the domains of development of a child, including motor skills, speech and language, cognitive skills, and social and emotional skills. This term should only be used to describe children younger than five years of age. Evidence: TAS. Frequency: Occasional (HP:0040283). (ORPHA:2220)
- Specific learning disability (HP:0001328): Impairment of certain skills such as reading or writing, coordination, self-control, or attention that interfere with the ability to learn. The impairment is not related to a global deficiency of intelligence. Evidence: TAS. Frequency: Occasional (HP:0040283). (ORPHA:2220)
- Delayed skeletal maturation (HP:0002750): A decreased rate of skeletal maturation. Delayed skeletal maturation can be diagnosed on the basis of an estimation of the bone age from radiographs of specific bones in the human body. Evidence: TAS. Frequency: Occasional (HP:0040283). (ORPHA:2220)